- Hypermetropia (HP:0000540): An abnormality of refraction characterized by the ability to see objects in the distance clearly, while objects nearby appear blurry. Evidence: TAS. (OMIM:612868)
- Ectopia pupillae (HP:0009918): A malposition of the pupil owing to a developmental defect of the iris. Evidence: TAS. Frequency: Occasional (HP:0040283). (OMIM:612868)
- Corneal dystrophy (HP:0001131): The term corneal dystrophy embraces a heterogenous group of bilateral genetically determined non-inflammatory corneal diseases that are restricted to the cornea. Evidence: IEA. (OMIM:612868)
- Nonprogressive (HP:0003680): Applies to a disease manifestation that does not increase in scope or severity over the course of time, i.e., that does not worsen with age. Evidence: TAS. (OMIM:612868)
- Infantile onset (HP:0003593): Onset of signs or symptoms of disease between 28 days to one year of life. Evidence: TAS. (OMIM:612868)
- Iris coloboma (HP:0000612): A coloboma of the iris. Evidence: TAS. Frequency: Occasional (HP:0040283). (OMIM:612868)
- Autosomal dominant inheritance (HP:0000006): A mode of inheritance that is observed for traits related to a gene encoded on one of the autosomes (i.e., the human chromosomes 1-22) in which a trait manifests in heterozygotes. In the context of medical genetics, an autosomal dominant disorder is caused when a single copy of the mutant allele is present. Males and females are affected equally, and can both transmit the disorder with a risk of 50% for each child of inheriting the mutant allele. Evidence: TAS. (OMIM:612868)
These phenotypes are associated with the disease posterior amorphous corneal dystrophy (OMIM:612868).